Phenotypes associated with the disease pyloric atresia (OMIM:265950):
- Polyhydramnios (HP:0001561): The presence of excess amniotic fluid in the uterus during pregnancy. Evidence: IEA. (OMIM:265950)
- Congenital pyloric atresia (HP:0004399): Congenital atresia of the pylorus. Evidence: IEA. (OMIM:265950)
- Autosomal recessive inheritance (HP:0000007): A mode of inheritance that is observed for traits related to a gene encoded on one of the autosomes (i.e., the human chromosomes 1-22) in which a trait manifests in individuals with two pathogenic alleles, either homozygotes (two copies of the same mutant allele) or compound heterozygotes (whereby each copy of a gene has a distinct mutant allele). Evidence: IEA. (OMIM:265950)